Phenotypes associated with the disease trichothiodystrophy 9, nonphotosensitive (OMIM:619692):
- Epicanthus (HP:0000286): A fold of skin starting above the medial aspect of the upper eyelid and arching downward to cover, pass in front of and lateral to the medial canthus. Evidence: PCS. Frequency: 1/1. (PMID:33909043)
- Brachydactyly (HP:0001156): Digits that appear disproportionately short compared to the hand/foot. The word brachydactyly is used here to describe a series distinct patterns of shortened digits (brachydactyly types A-E). This is the sense used here. Evidence: PCS. Frequency: 1/1. (PMID:33909043)
- Joint hypermobility (HP:0001382): The capability that a joint (or a group of joints) has to move, passively and/or actively, beyond normal limits along physiological axes. Evidence: PCS. Frequency: 1/1. (PMID:33909043)
- Global developmental delay (HP:0001263): A delay in the achievement of motor or mental milestones in the domains of development of a child, including motor skills, speech and language, cognitive skills, and social and emotional skills. This term should only be used to describe children younger than five years of age. Evidence: PCS. Frequency: 1/1. (PMID:33909043)
- Ataxia (HP:0001251): Ataxia refers to impaired coordination of voluntary muscle movement. Cerebellar ataxia refers to ataxia due to dysfunction of the cerebellum. This causes a variety of elementary neurological deficits including asynergy (lack of coordination between muscles, limbs and joints), dysmetria (lack of ability to judge distances that can lead to under- or overshoot in grasping movements), and dysdiadochokinesia (inability to perform rapid movements requiring antagonizing muscle groups to be switched on and off repeatedly). Evidence: PCS. Frequency: 1/1. (PMID:33909043)
- Infantile onset (HP:0003593): Onset of signs or symptoms of disease between 28 days to one year of life. Evidence: PCS. Frequency: 1/1. (PMID:33909043)
- Tiger tail banding (HP:0045055): An abnormal appearance of hair under polarizing microscopy (using crossed polarizers), whereby hair shafts show striking alternating bright and dark bands, often referred to as tiger tail banding. Evidence: PCS. Frequency: 1/1. (PMID:33909043)
- Sparse eyebrow (HP:0045075): Decreased density/number of eyebrow hairs. Evidence: PCS. Frequency: 1/1. (PMID:33909043)
- Sparse hair (HP:0008070): Reduced density of hairs. Evidence: PCS. Frequency: 1/1. (PMID:33909043)
- Ichthyosis (HP:0008064): An abnormality of the skin characterized the presence of excessive amounts of dry surface scales on the skin resulting from an abnormality of keratinization. Evidence: PCS. Frequency: 1/1. (PMID:33909043)
- Keratosis pilaris (HP:0032152): An anomaly of the hair follicles of the skin that typically presents as small, rough, brown folliculocentric papules distributed over characteristic areas of the skin, particularly the outer-upper arms and thighs. Evidence: PCS. Frequency: 1/1. (PMID:33909043)
- Autosomal recessive inheritance (HP:0000007): A mode of inheritance that is observed for traits related to a gene encoded on one of the autosomes (i.e., the human chromosomes 1-22) in which a trait manifests in individuals with two pathogenic alleles, either homozygotes (two copies of the same mutant allele) or compound heterozygotes (whereby each copy of a gene has a distinct mutant allele). Evidence: PCS. (PMID:33909043)
- Dental malocclusion (HP:0000689): Dental malocclusion refers to an abnormality of the occlusion, or alignment, of the teeth and the way the upper and lower teeth fit together, resulting in overcrowding of teeth or in abnormal bite patterns. Evidence: PCS. Frequency: 1/1. (PMID:33909043)
- High, narrow palate (HP:0002705): The presence of a high and narrow palate. Evidence: PCS. Frequency: 1/1. (PMID:33909043)
- Nail dystrophy (HP:0008404): Onychodystrophy (nail dystrophy) refers to nail changes apart from changes of the color (nail dyschromia) and involves partial or complete disruption of the various keratinous layers of the nail plate. Evidence: PCS. Frequency: 1/1. (PMID:33909043)
- Intellectual disability (HP:0001249): The term intellectual disability or intellectual developmental disorder is used to describe significantly sub-average intellectual and adaptive functioning based on clinical assessment and as measured by individually administered, appropriately normed, standardized and validated tests of intellectual functioning and adaptive behavior, with onset during the developmental period from infancy through adolescence. Evidence: PCS. Frequency: 1/1. (PMID:33909043)
- Diminished deep tendon reflex (HP:0001315): A reduction (hyporeflexia) or complete absence (areflexia) of the involuntary muscle contraction normally elicited by a reflex stimulus, such as tapping a deep tendon. Evidence: PCS. Frequency: 1/1. (PMID:33909043)